- Recurrent sinopulmonary infections (HP:0005425): An increased susceptibility to infections involving both the paranasal sinuses and the lungs, as manifested by a history of recurrent sinopulmonary infections. Evidence: IEA. (OMIM:279000)
- Congenital pulmonary airway malformation (HP:0010959): Congenital pulmonary airway malformation (CPAM) - previously known as congenital cystic adenomatoid malformation (CCAM) - is a relatively rare developmental malformation of the lower respiratory tract. It is a hamartomatous, dysplastic developmental abnormality of the lung characterized by abnormal airway patterning during lung branching morphogenesis and is formed by abnormal branching of the immature bronchioles. Evidence: IEA. (OMIM:279000)
- Bronchiectasis (HP:0002110): Persistent abnormal dilatation of the bronchi owing to localized and irreversible destruction and widening of the large airways. Evidence: IEA. (OMIM:279000)
- Autosomal recessive inheritance (HP:0000007): A mode of inheritance that is observed for traits related to a gene encoded on one of the autosomes (i.e., the human chromosomes 1-22) in which a trait manifests in individuals with two pathogenic alleles, either homozygotes (two copies of the same mutant allele) or compound heterozygotes (whereby each copy of a gene has a distinct mutant allele). Evidence: IEA. (OMIM:279000)
- Recurrent bronchitis (HP:0002837): An increased susceptibility to bronchitis as manifested by a history of recurrent bronchitis. Evidence: IEA. (OMIM:279000)
- Azoospermia (HP:0000027): Absence of any measurable level of sperm,whereby spermatozoa cannot be observed even after centrifugation of the semen pellet. Evidence: IEA. (OMIM:279000)
These phenotypes are associated with the disease Young syndrome (OMIM:279000).